- Polycystic kidney dysplasia (HP:0000113): The presence of multiple cysts in both kidneys. Evidence: TAS. Frequency: Frequent (HP:0040282). (ORPHA:261290)
- Hydronephrosis (HP:0000126): Severe distention of the kidney with dilation of the renal pelvis and calices. Evidence: TAS. Frequency: Frequent (HP:0040282). (ORPHA:261290)
- Wide mouth (HP:0000154): Distance between the oral commissures more than 2 SD above the mean. Alternatively, an apparently increased width of the oral aperture (subjective). Evidence: TAS. Frequency: Occasional (HP:0040283). (ORPHA:261290)
- Macroglossia (HP:0000158): Increased length and width of the tongue. Evidence: TAS. Frequency: Occasional (HP:0040283). (ORPHA:261290)
- Narrow mouth (HP:0000160): Distance between the commissures of the mouth more than 2 SD below the mean. Alternatively, an apparently decreased width of the oral aperture (subjective). Evidence: TAS. Frequency: Frequent (HP:0040282). (ORPHA:261290)
- Cleft palate (HP:0000175): Cleft palate is a developmental defect of the palate resulting from a failure of fusion of the palatine processes and manifesting as a separation of the roof of the mouth (soft and hard palate). Evidence: TAS. Frequency: Occasional (HP:0040283). (ORPHA:261290)
- Orofacial cleft (HP:0000202): The presence of a cleft (gap, opening, or groove) in the oral cavity, including cleft of the upper lip and/or cleft of the palate. Cleft of the upper lip is visible as a groove or fissure in the lip, most frequently due to a congenital failure of the maxillary and median nasal processes to fuse. Cleft palate is characterized by a grooved depression or fissure in the roof of the mouth, most often resulting from a congenital failure of the palate to fuse properly. Clefts of the lip and palate can occur individually or together. It is preferable to code each defect separately. Evidence: TAS. Frequency: Occasional (HP:0040283). (ORPHA:261290)
- High palate (HP:0000218): Height of the palate more than 2 SD above the mean (objective) or palatal height at the level of the first permanent molar more than twice the height of the teeth (subjective). Evidence: TAS. Frequency: Frequent (HP:0040282). (ORPHA:261290)
- Hydrocephalus (HP:0000238): Hydrocephalus is an active distension of the ventricular system of the brain resulting from inadequate passage of CSF from its point of production within the cerebral ventricles to its point of absorption into the systemic circulation. Evidence: TAS. Frequency: Occasional (HP:0040283). (ORPHA:261290)
- Microcephaly (HP:0000252): Head circumference below 2 standard deviations below the mean for age and gender. Evidence: TAS. Frequency: Very frequent (HP:0040281). (ORPHA:261290)
- Malar flattening (HP:0000272): Underdevelopment of the malar prominence of the jugal bone (zygomatic bone in mammals), appreciated in profile, frontal view, and/or by palpation. Evidence: TAS. Frequency: Frequent (HP:0040282). (ORPHA:261290)
- Coarse facial features (HP:0000280): Absence of fine and sharp appearance of brows, nose, lips, mouth, and chin, usually because of rounded and heavy features or thickened skin with or without thickening of subcutaneous and bony tissues. Evidence: TAS. Frequency: Occasional (HP:0040283). (ORPHA:261290)
- Hypertelorism (HP:0000316): Interpupillary distance more than 2 SD above the mean (alternatively, the appearance of an increased interpupillary distance or widely spaced eyes). Evidence: TAS. Frequency: Frequent (HP:0040282). (ORPHA:261290)
- Smooth philtrum (HP:0000319): Flat skin surface, with no ridge formation in the central region of the upper lip between the nasal base and upper vermilion border. Evidence: TAS. Frequency: Occasional (HP:0040283). (ORPHA:261290)
- Micrognathia (HP:0000347): Developmental hypoplasia of the mandible. Evidence: TAS. Frequency: Very frequent (HP:0040281). (ORPHA:261290)
- Hearing impairment (HP:0000365): A decreased magnitude of the sensory perception of sound. Evidence: TAS. Frequency: Occasional (HP:0040283). (ORPHA:261290)
- Low-set ears (HP:0000369): Upper insertion of the ear to the scalp below an imaginary horizontal line drawn between the inner canthi of the eye and extending posteriorly to the ear. Evidence: TAS. Frequency: Very frequent (HP:0040281). (ORPHA:261290)
- Wide nose (HP:0000445): Interalar distance more than two standard deviations above the mean for age, i.e., an apparently increased width of the nasal base and alae. Evidence: TAS. Frequency: Frequent (HP:0040282). (ORPHA:261290)
- Prominent nose (HP:0000448): Distance between subnasale and pronasale more than two standard deviations above the mean, or alternatively, an apparently increased anterior protrusion of the nasal tip. Evidence: TAS. Frequency: Occasional (HP:0040283). (ORPHA:261290)
- Short neck (HP:0000470): Diminished length of the neck. Evidence: TAS. Frequency: Frequent (HP:0040282). (ORPHA:261290)
- Strabismus (HP:0000486): A misalignment of the eyes so that the visual axes deviate from bifoveal fixation. The classification of strabismus may be based on a number of features including the relative position of the eyes, whether the deviation is latent or manifest, intermittent or constant, concomitant or otherwise and according to the age of onset and the relevance of any associated refractive error. Evidence: TAS. Frequency: Occasional (HP:0040283). (ORPHA:261290)
- Downslanted palpebral fissures (HP:0000494): The palpebral fissure inclination is more than two standard deviations below the mean. Evidence: TAS. Frequency: Occasional (HP:0040283). (ORPHA:261290)
- Ptosis (HP:0000508): The upper eyelid margin is positioned 3 mm or more lower than usual and covers the superior portion of the iris (objective); or, the upper lid margin obscures at least part of the pupil (subjective). Evidence: TAS. Frequency: Frequent (HP:0040282). (ORPHA:261290)
- Cataract (HP:0000518): A cataract is an opacity or clouding that develops in the crystalline lens of the eye or in its capsule. Evidence: TAS. Frequency: Occasional (HP:0040283). (ORPHA:261290)
- Tapered finger (HP:0001182): The gradual reduction in girth of the finger from proximal to distal. Evidence: TAS. Frequency: Occasional (HP:0040283). (ORPHA:261290)
- Intellectual disability (HP:0001249): The term intellectual disability or intellectual developmental disorder is used to describe significantly sub-average intellectual and adaptive functioning based on clinical assessment and as measured by individually administered, appropriately normed, standardized and validated tests of intellectual functioning and adaptive behavior, with onset during the developmental period from infancy through adolescence. Evidence: TAS. Frequency: Very frequent (HP:0040281). (ORPHA:261290)
- Hypotonia (HP:0001252): Hypotonia is an abnormally low muscle tone (the amount of tension or resistance to movement in a muscle). Even when relaxed, muscles have a continuous and passive partial contraction which provides some resistance to passive stretching. Hypotonia thus manifests as diminished resistance to passive stretching. Hypotonia is not the same as muscle weakness, although the two conditions can co-exist. Evidence: TAS. Frequency: Very frequent (HP:0040281). (ORPHA:261290)
- Global developmental delay (HP:0001263): A delay in the achievement of motor or mental milestones in the domains of development of a child, including motor skills, speech and language, cognitive skills, and social and emotional skills. This term should only be used to describe children younger than five years of age. Evidence: TAS. Frequency: Very frequent (HP:0040281). (ORPHA:261290)
- Hypertonia (HP:0001276): A condition in which there is increased muscle tone so that arms or legs, for example, are stiff and difficult to move. Evidence: TAS. Frequency: Frequent (HP:0040282). (ORPHA:261290)
- Flexion contracture (HP:0001371): A flexion contracture is a bent (flexed) joint that cannot be straightened actively or passively. It is thus a chronic loss of joint motion due to structural changes in muscle, tendons, ligaments, or skin that prevents normal movement of joints. Evidence: TAS. Frequency: Frequent (HP:0040282). (ORPHA:261290)
- Growth delay (HP:0001510): A deficiency or slowing down of growth pre- and postnatally. Evidence: TAS. Frequency: Frequent (HP:0040282). (ORPHA:261290)
- Intrauterine growth retardation (HP:0001511): An abnormal restriction of fetal growth with fetal weight below the tenth percentile for gestational age. Evidence: TAS. Frequency: Very frequent (HP:0040281). (ORPHA:261290)
- Patent ductus arteriosus (HP:0001643): In utero, the ductus arteriosus (DA) serves to divert ventricular output away from the lungs and toward the placenta by connecting the main pulmonary artery to the descending aorta. A patent ductus arteriosus (PDA) in the first 3 days of life is a physiologic shunt in healthy term and preterm newborn infants, and normally is substantially closed within about 24 hours after bith and completely closed after about three weeks. Failure of physiologcal closure is referred to a persistent or patent ductus arteriosus (PDA). Depending on the degree of left-to-right shunting, PDA can have clinical consequences. Evidence: TAS. Frequency: Occasional (HP:0040283). (ORPHA:261290)
- Aortic valve stenosis (HP:0001650): The presence of a stenosis (narrowing) of the aortic valve. Evidence: TAS. Frequency: Occasional (HP:0040283). (ORPHA:261290)
- Talipes (HP:0001883): A deformity of foot and ankle that has different subtypes that are talipes equinovarus, talipes equinovalgus, talipes calcaneovarus and talipes calcaneovalgus. Evidence: TAS. Frequency: Occasional (HP:0040283). (ORPHA:261290)
- Low posterior hairline (HP:0002162): Hair on the neck extends more inferiorly than usual. Evidence: TAS. Frequency: Occasional (HP:0040283). (ORPHA:261290)
- Generalized hirsutism (HP:0002230): Abnormally increased hair growth over much of the entire body. Evidence: TAS. Frequency: Frequent (HP:0040282). (ORPHA:261290)
- Scoliosis (HP:0002650): The presence of an abnormal lateral curvature of the spine. Evidence: TAS. Frequency: Occasional (HP:0040283). (ORPHA:261290)
- Skeletal muscle atrophy (HP:0003202): The presence of skeletal muscular atrophy (which is also known as amyotrophy). Evidence: TAS. Frequency: Occasional (HP:0040283). (ORPHA:261290)
- Clinodactyly of the 5th finger (HP:0004209): Clinodactyly refers to a bending or curvature of the fifth finger in the radial direction (i.e., towards the 4th finger). Evidence: TAS. Frequency: Very frequent (HP:0040281). (ORPHA:261290)
- Short stature (HP:0004322): A height below that which is expected according to age and gender norms. Although there is no universally accepted definition of short stature, many refer to "short stature" as height more than 2 standard deviations below the mean for age and gender (or below the 3rd percentile for age and gender dependent norms). Evidence: TAS. Frequency: Very frequent (HP:0040281). (ORPHA:261290)
- Hypoplastic left ventricle (HP:0004383): A severe congenital heart defect characterized by underdevelopment of the left ventricle. Evidence: TAS. Frequency: Occasional (HP:0040283). (ORPHA:261290)
- Prominent metopic ridge (HP:0005487): Vertical bony ridge positioned in the midline of the forehead. Evidence: TAS. Frequency: Occasional (HP:0040283). (ORPHA:261290)
- Urethral stenosis (HP:0008661): Abnormal narrowing of the urethra. Evidence: TAS. Frequency: Frequent (HP:0040282). (ORPHA:261290)
- Hypoplasia of penis (HP:0008736). Evidence: TAS. Frequency: Frequent (HP:0040282). (ORPHA:261290)
- High anterior hairline (HP:0009890): Distance between the hairline (trichion) and the glabella (the most prominent point on the frontal bone above the root of the nose), in the midline, more than two SD above the mean. Alternatively, an apparently increased distance between the hairline and the glabella. Evidence: TAS. Frequency: Occasional (HP:0040283). (ORPHA:261290)
- Thick nasal alae (HP:0009928): Increase in bulk of the ala nasi. Evidence: TAS. Frequency: Occasional (HP:0040283). (ORPHA:261290)
- Urethral valve (HP:0010481): The presence of an abnormal membrane obstructing the urethra. Evidence: TAS. Frequency: Frequent (HP:0040282). (ORPHA:261290)
- Broad eyebrow (HP:0011229): Regional increase in the width (height) of the eyebrow. Evidence: TAS. Frequency: Occasional (HP:0040283). (ORPHA:261290)
- Thick vermilion border (HP:0012471): Increased width of the skin of vermilion border region of upper lip. Evidence: TAS. Frequency: Occasional (HP:0040283). (ORPHA:261290)
These phenotypes are associated with the disease Trisomy 17p syndrome (ORPHA:261290).